- Anteverted nares (HP:0000463, a Human Phenotype Ontology term): Anteriorly-facing nostrils viewed with the head in the Frankfurt horizontal and the eyes of the observer level with the eyes of the subject. This gives the appearance of an upturned nose (upturned nasal tip). Evidence: TAS. Frequency: Frequent (HP:0040282, a Human Phenotype Ontology term). (ORPHA:2015)
- Cleft palate (HP:0000175, a Human Phenotype Ontology term): Cleft palate is a developmental defect of the palate resulting from a failure of fusion of the palatine processes and manifesting as a separation of the roof of the mouth (soft and hard palate). Evidence: TAS. Frequency: Frequent (HP:0040282, a Human Phenotype Ontology term). (ORPHA:2015)
- Thin upper lip vermilion (HP:0000219, a Human Phenotype Ontology term): Height of the vermilion of the upper lip in the midline more than 2 SD below the mean. Alternatively, an apparently reduced height of the vermilion of the upper lip in the frontal view (subjective). Evidence: TAS. Frequency: Frequent (HP:0040282, a Human Phenotype Ontology term). (ORPHA:2015)
- Epicanthus (HP:0000286, a Human Phenotype Ontology term): A fold of skin starting above the medial aspect of the upper eyelid and arching downward to cover, pass in front of and lateral to the medial canthus. Evidence: TAS. Frequency: Frequent (HP:0040282, a Human Phenotype Ontology term). (ORPHA:2015)
- Micrognathia (HP:0000347, a Human Phenotype Ontology term): Developmental hypoplasia of the mandible. Evidence: TAS. Frequency: Frequent (HP:0040282, a Human Phenotype Ontology term). (ORPHA:2015)
- Short neck (HP:0000470, a Human Phenotype Ontology term): Diminished length of the neck. Evidence: TAS. Frequency: Frequent (HP:0040282, a Human Phenotype Ontology term). (ORPHA:2015)
- Intellectual disability (HP:0001249, a Human Phenotype Ontology term): The term intellectual disability or intellectual developmental disorder is used to describe significantly sub-average intellectual and adaptive functioning based on clinical assessment and as measured by individually administered, appropriately normed, standardized and validated tests of intellectual functioning and adaptive behavior, with onset during the developmental period from infancy through adolescence. Evidence: TAS. Frequency: Frequent (HP:0040282, a Human Phenotype Ontology term). (ORPHA:2015)
- Short nose (HP:0003196, a Human Phenotype Ontology term): Distance from nasion to subnasale more than two standard deviations below the mean, or alternatively, an apparently decreased length from the nasal root to the nasal tip. Evidence: TAS. Frequency: Frequent (HP:0040282, a Human Phenotype Ontology term). (ORPHA:2015)
- Abnormal vertebral morphology (HP:0003468, a Human Phenotype Ontology term): An abnormality of one or more of the vertebrae. Evidence: TAS. Frequency: Frequent (HP:0040282, a Human Phenotype Ontology term). (ORPHA:2015)
- Short stature (HP:0004322, a Human Phenotype Ontology term): A height below that which is expected according to age and gender norms. Although there is no universally accepted definition of short stature, many refer to "short stature" as height more than 2 standard deviations below the mean for age and gender (or below the 3rd percentile for age and gender dependent norms). Evidence: TAS. Frequency: Frequent (HP:0040282, a Human Phenotype Ontology term). (ORPHA:2015)
- Posteriorly rotated ears (HP:0000358, a Human Phenotype Ontology term): A type of abnormal location of the ears in which the position of the ears is characterized by posterior rotation (the superior part of the ears is rotated towards the back of the head, and the inferior part of the ears towards the front). Evidence: TAS. Frequency: Frequent (HP:0040282, a Human Phenotype Ontology term). (ORPHA:2015)
These phenotypes are associated with the disease Cleft palate-short stature-vertebral anomalies syndrome (ORPHA:2015, an Orphanet rare-disease identifier).